- Thromboembolism (HP:0001907): The formation of a blood clot inside a blood vessel that subsequently travels through the blood stream from the site where it formed to another location in the body, generally leading to vascular occlusion at the distant site. Evidence: TAS. Frequency: Very frequent (HP:0040281). (ORPHA:3325)
- Autoimmune thrombocytopenia (HP:0001973): The presence of thrombocytopenia in combination with detection of antiplatelet antibodies. Evidence: TAS. Frequency: Very frequent (HP:0040281). (ORPHA:3325)
- Hypercoagulability (HP:0100724): An abnormality of coagulation associated with an increased risk of thrombosis. Evidence: TAS. Frequency: Very frequent (HP:0040281). (ORPHA:3325)
- Deep venous thrombosis (HP:0002625): Formation of a blot clot in a deep vein. The clot often blocks blood flow, causing swelling and pain. The deep veins of the leg are most often affected. Evidence: TAS. Frequency: Frequent (HP:0040282). (ORPHA:3325)
- Increased serum serotonin (HP:0003144): A increased concentration of serotonin in the blood. Evidence: TAS. Frequency: Frequent (HP:0040282). (ORPHA:3325)
- Arterial thrombosis (HP:0004420): The formation of a blood clot inside an artery. Evidence: TAS. Frequency: Frequent (HP:0040282). (ORPHA:3325)
- Venous thrombosis (HP:0004936): Formation of a blood clot (thrombus) inside a vein, causing the obstruction of blood flow. Evidence: TAS. Frequency: Frequent (HP:0040282). (ORPHA:3325)
- Stroke (HP:0001297): Sudden impairment of blood flow to a part of the brain due to occlusion or rupture of an artery to the brain. Evidence: TAS. Frequency: Occasional (HP:0040283). (ORPHA:3325)
- Myocardial infarction (HP:0001658): Necrosis of the myocardium caused by an obstruction of the blood supply to the heart and often associated with chest pain, shortness of breath, palpitations, and anxiety as well as characteristic EKG findings and elevation of serum markers including creatine kinase-MB fraction and troponin. Evidence: TAS. Frequency: Occasional (HP:0040283). (ORPHA:3325)
- Pulmonary embolism (HP:0002204): An embolus (that is, an abnormal particle circulating in the blood) located in the pulmonary artery and thereby blocking blood circulation to the lung. Usually the embolus is a blood clot that has developed in an extremity (for instance, a deep venous thrombosis), detached, and traveled through the circulation before becoming trapped in the pulmonary artery. Evidence: TAS. Frequency: Occasional (HP:0040283). (ORPHA:3325)
- Cerebral ischemia (HP:0002637): Restriction of arterial blood supply to the brain associated with insufficient oxygenation to support the metabolic requirements of the tissue. Evidence: TAS. Frequency: Occasional (HP:0040283). (ORPHA:3325)
- Disseminated intravascular coagulation (HP:0005521): Disseminated intravascular coagulation is characterized by the widespread activation of coagulation, which results in the intravascular formation of fibrin and ultimately thrombotic occlusion of small and midsize vessels. Evidence: TAS. Frequency: Occasional (HP:0040283). (ORPHA:3325)
- Increased inflammatory response (HP:0012649): A abnormal increase in the inflammatory response to injury or infection. Evidence: TAS. Frequency: Occasional (HP:0040283). (ORPHA:3325)
- Mesenteric venous thrombosis (HP:0030248): A clot that obstructs blood flow in a mesenteric vein (the superior and the inferior mesenteric vein drain blood from the small and large intestine). Evidence: TAS. Frequency: Occasional (HP:0040283). (ORPHA:3325)
- Abnormal onset of bleeding (HP:0040231). Evidence: TAS. Frequency: Very rare (HP:0040284). (ORPHA:3325)
These phenotypes are associated with the disease Classic heparin-induced thrombocytopenia (ORPHA:3325).